- Macular degeneration (HP:0000608): A nonspecific term denoting degeneration of the retinal pigment epithelium and/or retinal photoreceptor cells of the macula lutea. Evidence: TAS. (OMIM:610149)
- Polygenic inheritance (HP:0010982): A mode of inheritance that depends on a mixture of major and minor genetic determinants possibly together with environmental factors. Diseases inherited in this manner are termed complex diseases. Evidence: TAS. (OMIM:610149)
These phenotypes are associated with the disease age related macular degeneration 7 (OMIM:610149).